- Pinealoma (HP:0010799): A neoplasm of the pineal gland. Evidence: TAS. Frequency: Obligate (HP:0040280). (ORPHA:251909)
- Headache (HP:0002315): Cephalgia, or pain sensed in various parts of the head, not confined to the area of distribution of any nerve. Evidence: TAS. Frequency: Very frequent (HP:0040281). (ORPHA:251909)
- Atypical behavior (HP:0000708): Atypical behavior is an abnormality in a person's actions that can be controlled or modulated by the will of the individual. While abnormal behaviors can be difficult to control, they are distinct from other abnormal actions that cannot be affected by the individual's will. Evidence: TAS. Frequency: Frequent (HP:0040282). (ORPHA:251909)
- Progressive neurologic deterioration (HP:0002344). Evidence: TAS. Frequency: Frequent (HP:0040282). (ORPHA:251909)
- Memory impairment (HP:0002354): An impairment of memory as manifested by a reduced ability to remember things such as dates and names, and increased forgetfulness. Evidence: TAS. Frequency: Frequent (HP:0040282). (ORPHA:251909)
- Increased intracranial pressure (HP:0002516): An increase of the pressure inside the cranium (skull) and thereby in the brain tissue and cerebrospinal fluid. Evidence: TAS. Frequency: Frequent (HP:0040282). (ORPHA:251909)
- Cognitive impairment (HP:0100543): Abnormal cognition is characterized by deficits in thinking, reasoning, or remembering. Evidence: TAS. Frequency: Frequent (HP:0040282). (ORPHA:251909)
- Impaired convergence (HP:0000619): Reduced ability to turn the eyes inward in order to focus on a nearby object. Evidence: TAS. Frequency: Occasional (HP:0040283). (ORPHA:251909)
- Sensory neuropathy (HP:0000763): Peripheral neuropathy affecting the sensory nerves. Evidence: TAS. Frequency: Occasional (HP:0040283). (ORPHA:251909)
- Papilledema (HP:0001085): Papilledema refers to edema (swelling) of the optic disc secondary to any factor which increases cerebral spinal fluid pressure. Evidence: TAS. Frequency: Occasional (HP:0040283). (ORPHA:251909)
- Seizure (HP:0001250): A seizure is an intermittent abnormality of nervous system physiology characterized by a transient occurrence of signs and/or symptoms due to abnormal excessive or synchronous neuronal activity in the brain. Evidence: TAS. Frequency: Occasional (HP:0040283). (ORPHA:251909)
- Paralysis (HP:0003470): Paralysis of voluntary muscles means loss of contraction due to interruption of one or more motor pathways from the brain to the muscle fibers. Although the word paralysis is often used interchangeably to mean either complete or partial loss of muscle strength, it is preferable to use paralysis or plegia for complete or severe loss of muscle strength, and paresis for partial or slight loss. Motor paralysis results from deficits of the upper motor neurons (corticospinal, corticobulbar, or subcorticospinal). Motor paralysis is often accompanied by an impairment in the facility of movement. Evidence: TAS. Frequency: Occasional (HP:0040283). (ORPHA:251909)
- Midline brain calcifications (HP:0007045). Evidence: TAS. Frequency: Occasional (HP:0040283). (ORPHA:251909)
- Reduced visual acuity (HP:0007663). Evidence: TAS. Frequency: Occasional (HP:0040283). (ORPHA:251909)
- Progressive visual field defects (HP:0007987). Evidence: TAS. Frequency: Occasional (HP:0040283). (ORPHA:251909)
- Retinoblastoma (HP:0009919): A tumor of the eye originating from cells of the retina. Evidence: TAS. Frequency: Occasional (HP:0040283). (ORPHA:251909)
- Amaurosis fugax (HP:0100576): A transient visual disturbance that is typically caused by a circulatory, ocular or neurological underlying condition. Evidence: TAS. Frequency: Occasional (HP:0040283). (ORPHA:251909)
- Lethargy (HP:0001254): A state of fatigue, either physical or mental slowness and sluggishness, with difficulties in initiating or performing simple tasks. Distinguished from apathy which implies indifference and a lack of desire or interest in the task. A person with lethargy may have the desire, but not the energy to engage in personal or socially relevant tasks. Evidence: TAS. Frequency: Very rare (HP:0040284). (ORPHA:251909)
- Reduced consciousness (HP:0004372): Abnormally diminished level of attention, responsiveness, or wakefulness. Evidence: TAS. Frequency: Very rare (HP:0040284). (ORPHA:251909)
These phenotypes are associated with the disease Pineoblastoma (ORPHA:251909).